- Epicanthus (HP:0000286): A fold of skin starting above the medial aspect of the upper eyelid and arching downward to cover, pass in front of and lateral to the medial canthus. Evidence: PCS. Frequency: 2/2. (PMID:24697219)
- Tented upper lip vermilion (HP:0010804): Triangular appearance of the oral aperture with the apex in the midpoint of the upper vermilion and the lower vermilion forming the base. Evidence: PCS. Frequency: 2/2. (PMID:24697219)
- Congenital onset (HP:0003577): A phenotypic abnormality that is present at birth. Evidence: PCS. Frequency: 2/2. (PMID:24697219)
- Sleep disturbance (HP:0002360): An abnormal pattern in the quality, quantity, or characteristics of sleep. Evidence: PCS. Frequency: 2/2. (PMID:24697219)
- Ataxia (HP:0001251): Ataxia refers to impaired coordination of voluntary muscle movement. Cerebellar ataxia refers to ataxia due to dysfunction of the cerebellum. This causes a variety of elementary neurological deficits including asynergy (lack of coordination between muscles, limbs and joints), dysmetria (lack of ability to judge distances that can lead to under- or overshoot in grasping movements), and dysdiadochokinesia (inability to perform rapid movements requiring antagonizing muscle groups to be switched on and off repeatedly). Evidence: PCS. Frequency: 1/2. (PMID:24697219)
- Ventouse delivery (HP:0011412): Delivery of newborn by means of a ventouse, a vacuum device used to assist the delivery of a baby when the second stage of labor has not progressed adequately. Evidence: PCS. Frequency: 1/2. (PMID:24697219)
- Severe intellectual disability (HP:0010864): Severe intellectual disability (ID) is defined as a type of ID characterized by severely sub-average adaptive functioning and intellectual functioning, with an intelligence quotient (IQ) the range of 20-34. Evidence: PCS. Frequency: 2/2. (PMID:24697219)
- Infantile spasms (HP:0012469): Infantile spasms represent a subset of "epileptic spasms". Infantile Spasms are epileptic spasms starting in the first year of life (infancy). Evidence: PCS. Frequency: 1/2. (PMID:24697219)
- Aggressive behavior (HP:0000718): Behavior or an act aimed at harming a person, animal, or physical property (e.g., acts of physical violence; shouting, swearing, and using harsh language; slashing someone's tires). Evidence: PCS. Frequency: 2/2. (PMID:24697219)
- Motor stereotypy (HP:0000733): Use of the same abnormal action in response to certain triggers or at random. They may be used as a way to regulate one's internal state but must otherwise have no apparent functional purpose. Evidence: PCS. Frequency: 1/2. (PMID:24697219)
- High palate (HP:0000218): Height of the palate more than 2 SD above the mean (objective) or palatal height at the level of the first permanent molar more than twice the height of the teeth (subjective). Evidence: PCS. Frequency: 1/2. (PMID:24697219)
- Downturned corners of mouth (HP:0002714): A morphological abnormality of the mouth in which the angle of the mouth is downturned. The oral commissures are positioned inferior to the midline labial fissure. Evidence: PCS. Frequency: 2/2. (PMID:24697219)
- Bruxism (HP:0003763): Bruxism is characterized by the grinding of the teeth including the clenching of the jaw and typically occur during sleep. Evidence: PCS. Frequency: 1/2. (PMID:24697219)
- Microcephaly (HP:0000252): Head circumference below 2 standard deviations below the mean for age and gender. Evidence: PCS. Frequency: 2/2. (PMID:24697219)
- Generalized neonatal hypotonia (HP:0008935): Muscular hypotonia (abnormally low muscle tone) manifesting in the neonatal period and affecting the entire musculature. Evidence: PCS. Frequency: 2/2. (PMID:24697219)
- Downslanted palpebral fissures (HP:0000494): The palpebral fissure inclination is more than two standard deviations below the mean. Evidence: PCS. Frequency: 1/2. (PMID:24697219)
- Cerebral atrophy (HP:0002059): Atrophy (wasting, decrease in size of cells or tissue) affecting the cerebrum. Evidence: PCS. Frequency: 2/2. (PMID:24697219)
- Talipes equinovarus (HP:0001762): Talipes equinovarus (also called clubfoot) typically has four main components: inversion and adduction of the forefoot; inversion of the heel and hindfoot; equinus (limitation of extension) of the ankle and subtalar joint; and internal rotation of the leg. Evidence: PCS. Frequency: 1/2. (PMID:24697219)
- Absent speech (HP:0001344): Complete lack of development of speech and language abilities. Evidence: PCS. Frequency: 2/2. (PMID:24697219)
- Everted lower lip vermilion (HP:0000232): An abnormal configuration of the lower lip such that it is turned outward i.e., everted, with the Inner aspect of the lower lip vermilion (normally opposing the teeth) being visible in a frontal view. Evidence: PCS. Frequency: 2/2. (PMID:24697219)
- Full cheeks (HP:0000293): Increased prominence or roundness of soft tissues between zygomata and mandible. Evidence: PCS. Frequency: 1/2. (PMID:24697219)
- Deeply set eye (HP:0000490): An eye that is more deeply recessed into the plane of the face than is typical. Evidence: PCS. Frequency: 2/2. (PMID:24697219)
- Global developmental delay (HP:0001263): A delay in the achievement of motor or mental milestones in the domains of development of a child, including motor skills, speech and language, cognitive skills, and social and emotional skills. This term should only be used to describe children younger than five years of age. Evidence: PCS. Frequency: 2/2. (PMID:24697219)
- Generalized tonic seizure (HP:0010818): A generalized tonic seizure is a type of generalized motor seizure characterized by bilateral limb stiffening or elevation, often with neck stiffening without a subsequent clonic phase. The tonic activity can be a sustained abnormal posture, either in extension or flexion, sometimes accompanied by tremor of the extremities. Evidence: PCS. Frequency: 1/2. (PMID:24697219)
- Depressed nasal bridge (HP:0005280): Posterior positioning of the nasal root in relation to the overall facial profile for age. Evidence: PCS. Frequency: 2/2. (PMID:24697219)
- Hair-pulling (HP:0012167): A phenomenon in which persons repetitively pull out their own hair, resulting in noticeable hair loss. Evidence: PCS. Frequency: 1/2. (PMID:24697219)
- Self-injurious behavior (HP:0100716): Self-aggression. Evidence: PCS. Frequency: 1/2. (PMID:24697219)
- Low-set ears (HP:0000369): Upper insertion of the ear to the scalp below an imaginary horizontal line drawn between the inner canthi of the eye and extending posteriorly to the ear. Evidence: PCS. Frequency: 1/2. (PMID:24697219)
- Autosomal dominant inheritance (HP:0000006): A mode of inheritance that is observed for traits related to a gene encoded on one of the autosomes (i.e., the human chromosomes 1-22) in which a trait manifests in heterozygotes. In the context of medical genetics, an autosomal dominant disorder is caused when a single copy of the mutant allele is present. Males and females are affected equally, and can both transmit the disorder with a risk of 50% for each child of inheriting the mutant allele. Evidence: PCS. (PMID:24697219)
These phenotypes are associated with the disease intellectual disability, autosomal dominant 38 (OMIM:616393).